Phenotypes associated with the disease Carnosinase deficiency (ORPHA:1361):
- Intellectual disability (HP:0001249): The term intellectual disability or intellectual developmental disorder is used to describe significantly sub-average intellectual and adaptive functioning based on clinical assessment and as measured by individually administered, appropriately normed, standardized and validated tests of intellectual functioning and adaptive behavior, with onset during the developmental period from infancy through adolescence. Evidence: TAS. Frequency: Very frequent (HP:0040281). (ORPHA:1361)
- Generalized myoclonic seizure (HP:0002123): A generalized myoclonic seizure is a type of generalized motor seizure characterized by bilateral, sudden, brief (<100 ms) involuntary single or multiple contraction of muscles or muscle groups of variable topography (axial, proximal limb, distal). Myoclonus is less regularly repetitive and less sustained than is clonus. Evidence: TAS. Frequency: Very frequent (HP:0040281). (ORPHA:1361)
- EEG abnormality (HP:0002353): Abnormality observed by electroencephalogram (EEG), which is used to record of the brain's spontaneous electrical activity from multiple electrodes placed on the scalp. Evidence: TAS. Frequency: Very frequent (HP:0040281). (ORPHA:1361)
- Developmental regression (HP:0002376): Loss of developmental skills, as manifested by loss of developmental milestones. Evidence: TAS. Frequency: Very frequent (HP:0040281). (ORPHA:1361)
- Carnosinuria (HP:0003167): An increased concentration of carnosine in the urine. Evidence: TAS. Frequency: Very frequent (HP:0040281). (ORPHA:1361)